Phenotypes associated with the disease BODY MASS INDEX QUANTITATIVE TRAIT LOCUS 9; BMIQ9 (OMIM:602025):
- Obesity (HP:0001513): Accumulation of substantial excess body fat. Evidence: TAS. (OMIM:602025)